- Trigonocephaly (HP:0000243): Wedge-shaped, or triangular head, with the apex of the triangle at the midline of the forehead and the base of the triangle at the occiput. Evidence: TAS. Frequency: Very frequent (HP:0040281). (ORPHA:3369)
- Global developmental delay (HP:0001263): A delay in the achievement of motor or mental milestones in the domains of development of a child, including motor skills, speech and language, cognitive skills, and social and emotional skills. This term should only be used to describe children younger than five years of age. Evidence: TAS. Frequency: Very frequent (HP:0040281). (ORPHA:3369)
- Short stature (HP:0004322): A height below that which is expected according to age and gender norms. Although there is no universally accepted definition of short stature, many refer to "short stature" as height more than 2 standard deviations below the mean for age and gender (or below the 3rd percentile for age and gender dependent norms). Evidence: TAS. Frequency: Very frequent (HP:0040281). (ORPHA:3369)
- Inguinal hernia (HP:0000023): Protrusion of the contents of the abdominal cavity through the inguinal canal. Evidence: TAS. Frequency: Frequent (HP:0040282). (ORPHA:3369)
- Broad secondary alveolar ridge (HP:0000216). Evidence: TAS. Frequency: Frequent (HP:0040282). (ORPHA:3369)
- High palate (HP:0000218): Height of the palate more than 2 SD above the mean (objective) or palatal height at the level of the first permanent molar more than twice the height of the teeth (subjective). Evidence: TAS. Frequency: Frequent (HP:0040282). (ORPHA:3369)
- Small anterior fontanelle (HP:0000237): Abnormally decreased size of the anterior fontanelle with respect to age-dependent norms. Evidence: TAS. Frequency: Frequent (HP:0040282). (ORPHA:3369)
- Epicanthus (HP:0000286): A fold of skin starting above the medial aspect of the upper eyelid and arching downward to cover, pass in front of and lateral to the medial canthus. Evidence: TAS. Frequency: Frequent (HP:0040282). (ORPHA:3369)
- Narrow forehead (HP:0000341): Width of the forehead or distance between the frontotemporales is more than two standard deviations below the mean (objective); or apparently narrow intertemporal region (subjective). Evidence: TAS. Frequency: Frequent (HP:0040282). (ORPHA:3369)
- Wide nasal bridge (HP:0000431): Increased breadth of the nasal bridge (and with it, the nasal root). Evidence: TAS. Frequency: Frequent (HP:0040282). (ORPHA:3369)
- Hypotelorism (HP:0000601): Interpupillary distance less than 2 SD below the mean (alternatively, the appearance of an decreased interpupillary distance or closely spaced eyes). Evidence: TAS. Frequency: Frequent (HP:0040282). (ORPHA:3369)
- Seizure (HP:0001250): A seizure is an intermittent abnormality of nervous system physiology characterized by a transient occurrence of signs and/or symptoms due to abnormal excessive or synchronous neuronal activity in the brain. Evidence: TAS. Frequency: Frequent (HP:0040282). (ORPHA:3369)
- Small for gestational age (HP:0001518): Smaller than normal size according to sex and gestational age related norms, defined as a weight below the 10th percentile for the gestational age. Evidence: TAS. Frequency: Frequent (HP:0040282). (ORPHA:3369)
- Ventricular septal defect (HP:0001629): A hole between the two bottom chambers (ventricles) of the heart. The defect is centered around the most superior aspect of the ventricular septum. Evidence: TAS. Frequency: Frequent (HP:0040282). (ORPHA:3369)
- Moderate intellectual disability (HP:0002342): Moderate intellectual disability (ID) is defined as a type of ID characterized by moderately sub-average adaptive functioning and intellectual functioning, with an intelligence quotient (IQ) the range of 35-49. Evidence: TAS. Frequency: Frequent (HP:0040282). (ORPHA:3369)
- Secondary microcephaly (HP:0005484): Head circumference which falls below 2 standard deviations below the mean for age and gender because of insufficient head growth after birth. Evidence: TAS. Frequency: Frequent (HP:0040282). (ORPHA:3369)
- Premature posterior fontanelle closure (HP:0005494). Evidence: TAS. Frequency: Frequent (HP:0040282). (ORPHA:3369)
- Metopic suture patent to nasal root (HP:0005495): The frontal suture divides the two halves of the frontal bone in infants and usually fuses by the age of six years. The suture runs from the bregma (the point on the skull at which the coronal suture is intersected perpendicularly by the sagittal suture) to the nasion or nasal root. This term applies if the suture is widely patent from bregma to nasal root. Evidence: TAS. Frequency: Frequent (HP:0040282). (ORPHA:3369)
- Fifth finger distal phalanx clinodactyly (HP:0005769): Bending or curvature of the distal phalanx of little finger in the radial direction (i.e., towards the 4th finger). Evidence: TAS. Frequency: Frequent (HP:0040282). (ORPHA:3369)
- Postnatal growth retardation (HP:0008897): Slow or limited growth after birth. Evidence: TAS. Frequency: Frequent (HP:0040282). (ORPHA:3369)
- Multiple suture craniosynostosis (HP:0011324): Craniosynostosis involving at least 2 cranial sutures, where the exact pattern of sutures fused has not been precisely specified. Evidence: TAS. Frequency: Frequent (HP:0040282). (ORPHA:3369)
- Posteriorly rotated ears (HP:0000358): A type of abnormal location of the ears in which the position of the ears is characterized by posterior rotation (the superior part of the ears is rotated towards the back of the head, and the inferior part of the ears towards the front). Evidence: TAS. Frequency: Frequent (HP:0040282). (ORPHA:3369)
- Convex nasal ridge (HP:0000444): Nasal ridge curving anteriorly to an imaginary line that connects the nasal root and tip. The nose appears often also prominent, and the columella low. Evidence: TAS. Frequency: Frequent (HP:0040282). (ORPHA:3369)
These phenotypes are associated with the disease Trigonocephaly-short stature-developmental delay syndrome (ORPHA:3369).